Phenotypes associated with the disease intellectual developmental disorder, autosomal recessive 79 (OMIM:620393):
- Delayed CNS myelination (HP:0002188): Delayed myelination in the central nervous system. Evidence: PCS. Frequency: 1/1. (PMID:34494102)
- Short hallux (HP:0010109): Underdevelopment (hypoplasia) of the big toe. Evidence: PCS. Frequency: 1/2. (PMID:34494102)
- Gait ataxia (HP:0002066): A type of ataxia characterized by the impairment of the ability to coordinate the movements required for normal walking. Gait ataxia is characteirzed by a wide-based staggering gait with a tendency to fall. Evidence: PCS. Frequency: 1/2. (PMID:34494102)
- Hypotonia (HP:0001252): Hypotonia is an abnormally low muscle tone (the amount of tension or resistance to movement in a muscle). Even when relaxed, muscles have a continuous and passive partial contraction which provides some resistance to passive stretching. Hypotonia thus manifests as diminished resistance to passive stretching. Hypotonia is not the same as muscle weakness, although the two conditions can co-exist. Evidence: PCS. Frequency: 1/2. (PMID:34494102)
- Infantile onset (HP:0003593): Onset of signs or symptoms of disease between 28 days to one year of life. Evidence: PCS. Frequency: 2/2. (PMID:34494102)
- Intention tremor (HP:0002080): A type of kinetic tremor that occurs during target directed movement is called intention tremor. That is, an oscillatory cerebellar ataxia that tends to be absent when the limbs are inactive and during the first part of voluntary movement but worsening as the movement continues and greater precision is required (e.g., in touching a target such as the patient's nose or a physician's finger). Evidence: PCS. Frequency: 1/2. (PMID:34494102)
- Severe intellectual disability (HP:0010864): Severe intellectual disability (ID) is defined as a type of ID characterized by severely sub-average adaptive functioning and intellectual functioning, with an intelligence quotient (IQ) the range of 20-34. Evidence: PCS. Frequency: 2/2. (PMID:34494102)
- Tongue thrusting (HP:0100703): Pressing forward of the tongue in the mouth, a retained motoric habit from infantile swallowing patterns. Evidence: PCS. Frequency: 1/2. (PMID:34494102)
- Ventricular septal defect (HP:0001629): A hole between the two bottom chambers (ventricles) of the heart. The defect is centered around the most superior aspect of the ventricular septum. Evidence: PCS. Frequency: 1/2. (PMID:34494102)
- Smooth philtrum (HP:0000319): Flat skin surface, with no ridge formation in the central region of the upper lip between the nasal base and upper vermilion border. Evidence: PCS. Frequency: 1/2. (PMID:34494102)
- Long fingers (HP:0100807): The middle finger is more than 2 SD above the mean for newborns 27 to 41 weeks EGA or above the 97th centile for children from birth to 16 years of age AND the five digits retain their normal length proportions relative to each other (i.e., it is not the case that the middle finger is the only lengthened digit), or, Fingers that appear disproportionately long compared to the palm of the hand. Evidence: PCS. Frequency: 1/2. (PMID:34494102)
- Oligomenorrhea (HP:0000876): Infrequent menses (less than 6 per year or more than 35 days between cycles). Evidence: PCS. Frequency: 1/2. (PMID:34494102)
- Thin upper lip vermilion (HP:0000219): Height of the vermilion of the upper lip in the midline more than 2 SD below the mean. Alternatively, an apparently reduced height of the vermilion of the upper lip in the frontal view (subjective). Evidence: PCS. Frequency: 1/2. (PMID:34494102)
- Broad nasal tip (HP:0000455): Increase in width of the nasal tip. Evidence: PCS. Frequency: 2/2. (PMID:34494102)
- Pes planus (HP:0001763): A foot where the longitudinal arch of the foot is in contact with the ground or floor when the individual is standing; or, in a patient lying supine, a foot where the arch is in contact with the surface of a flat board pressed against the sole of the foot by the examiner with a pressure similar to that expected from weight bearing; or, the height of the arch is reduced. Evidence: PCS. Frequency: 1/2. (PMID:34494102)
- Incoordination (HP:0002311): A deficit in coordination of muscle movements. Coordination is defined as the orchestrated movement of multiple body parts as required to accomplish intended actions, like walking. Evidence: PCS. Frequency: 1/2. (PMID:34494102)
- Broad-based gait (HP:0002136): An abnormal gait pattern in which persons stand and walk with their feet spaced widely apart. This is often a component of cerebellar ataxia. Evidence: PCS. Frequency: 1/2. (PMID:34494102)
- Wide nasal bridge (HP:0000431): Increased breadth of the nasal bridge (and with it, the nasal root). Evidence: PCS. Frequency: 1/2. (PMID:34494102)
- Feeding difficulties (HP:0011968): Impaired ability to eat related to problems gathering food and getting ready to suck, chew, or swallow it. Evidence: PCS. Frequency: 2/2. (PMID:34494102)
- Deeply set eye (HP:0000490): An eye that is more deeply recessed into the plane of the face than is typical. Evidence: PCS. Frequency: 2/2. (PMID:34494102)
- Global developmental delay (HP:0001263): A delay in the achievement of motor or mental milestones in the domains of development of a child, including motor skills, speech and language, cognitive skills, and social and emotional skills. This term should only be used to describe children younger than five years of age. Evidence: PCS. Frequency: 2/2. (PMID:34494102)
- Autosomal recessive inheritance (HP:0000007): A mode of inheritance that is observed for traits related to a gene encoded on one of the autosomes (i.e., the human chromosomes 1-22) in which a trait manifests in individuals with two pathogenic alleles, either homozygotes (two copies of the same mutant allele) or compound heterozygotes (whereby each copy of a gene has a distinct mutant allele). Evidence: PCS. (PMID:34494102)
- Eczematoid dermatitis (HP:0000964): Eczema is a form of dermatitis that is characterized by scaly, pruritic, erythematous lesions located on flexural surfaces. Evidence: PCS. Frequency: 1/2. (PMID:34494102)
- Clinodactyly of the 5th finger (HP:0004209): Clinodactyly refers to a bending or curvature of the fifth finger in the radial direction (i.e., towards the 4th finger). Evidence: PCS. Frequency: 1/2. (PMID:34494102)
- Slender finger (HP:0001238): Fingers that are disproportionately narrow (reduced girth) for the hand/foot size or build of the individual. Evidence: PCS. Frequency: 2/2. (PMID:34494102)